- EEG abnormality (HP:0002353): Abnormality observed by electroencephalogram (EEG), which is used to record of the brain's spontaneous electrical activity from multiple electrodes placed on the scalp. Evidence: PCS. (OMIM:181500)
- Schizophrenia (HP:0100753): A mental disorder characterized by a disintegration of thought processes and emotional responsiveness. It most commonly manifests as auditory hallucinations, paranoid or bizarre delusions, or disorganized speech and thinking. It is accompanied by significant social or occupational dysfunction. The onset of symptoms typically occurs in young adulthood, with a global lifetime prevalence of about 1%. This term is not a helpful parent term to describe abnormal experiences. Evidence: TAS. (OMIM:181500)
- Hallucinations (HP:0000738): Perceptions in a conscious and awake state that, in the absence of external stimuli, have qualities of real perception. These perceptions are vivid, substantial, and located in external objective space. Evidence: IEA. (OMIM:181500)
- Social and occupational deterioration (HP:0007086). Evidence: IEA. (OMIM:181500)
- Negativism (HP:0410291): Opposing or not responding to instructions or external stimuli. Evidence: PCS. (PMID:7669819)
- Delusion (HP:0000746): A delusion is a fixed false belief held despite evidence to the contrary. The term delusion broadly encompasses all false judgments that possess the following external characteristics to a significant, albeit unspecified, extent: (1) they are held with an exceptional level of conviction, accompanied by an unparalleled subjective certainty; (2) there is an inability to consider alternative experiences or compelling counter-arguments; (3) the content of the belief is impossible. Evidence: IEA. (OMIM:181500)
- Autosomal dominant inheritance (HP:0000006): A mode of inheritance that is observed for traits related to a gene encoded on one of the autosomes (i.e., the human chromosomes 1-22) in which a trait manifests in heterozygotes. In the context of medical genetics, an autosomal dominant disorder is caused when a single copy of the mutant allele is present. Males and females are affected equally, and can both transmit the disorder with a risk of 50% for each child of inheriting the mutant allele. Evidence: TAS. (OMIM:181500)
These phenotypes are associated with the disease schizophrenia (OMIM:181500).